Phenotypes associated with the disease Meningioma (ORPHA:2495):
- Chromosomal breakage induced by ionizing radiation (HP:0010997): Increased amount of chromosomal breaks in cultured blood lymphocytes or other cells induced by treatment with ionizing radiation. Evidence: TAS. Frequency: Very frequent (HP:0040281). (ORPHA:2495)
- Increased sensitivity to ionizing radiation (HP:0011133): An abnormally increased sensitivity to the effects of ionizing radiation. Evidence: TAS. Frequency: Very frequent (HP:0040281). (ORPHA:2495)
- Intracranial meningioma (HP:0100009). Evidence: TAS. Frequency: Very frequent (HP:0040281). (ORPHA:2495)
- Hypogonadotropic hypogonadism (HP:0000044): Hypogonadotropic hypogonadism is characterized by reduced function of the gonads (testes in males or ovaries in females) and results from the absence of the gonadal stimulating pituitary hormones: follicle stimulating hormone (FSH) and luteinizing hormone (LH). Evidence: TAS. Frequency: Frequent (HP:0040282). (ORPHA:2495)
- Amenorrhea (HP:0000141): Absence of menses for an interval of time equivalent to a total of more than (or equal to) 3 previous cycles or 6 months. Evidence: TAS. Frequency: Frequent (HP:0040282). (ORPHA:2495)
- Impotence (HP:0000802): Inability to develop or maintain an erection of the penis. Evidence: TAS. Frequency: Frequent (HP:0040282). (ORPHA:2495)
- Increased circulating prolactin concentration (HP:0000870): The presence of abnormally increased levels of prolactin in the blood. Prolactin is a peptide hormone produced by the anterior pituitary gland that plays a role in breast development and lactation during pregnancy. Evidence: TAS. Frequency: Frequent (HP:0040282). (ORPHA:2495)
- Seizure (HP:0001250): A seizure is an intermittent abnormality of nervous system physiology characterized by a transient occurrence of signs and/or symptoms due to abnormal excessive or synchronous neuronal activity in the brain. Evidence: TAS. Frequency: Frequent (HP:0040282). (ORPHA:2495)
- Nausea and vomiting (HP:0002017): Nausea is a commonly encountered symptom that has been defined as an unpleasant painless subjective feeling that one will imminently vomit. Vomiting has been defined as the forceful expulsion of the contents of the stomach, duodenum, or jejunum through the oral cavity. While nausea and vomiting are often thought to exist on a temporal continuum, this is not always the case. There are situations when severe nausea may be present without emesis and less frequently, when emesis may be present without preceding nausea. Evidence: TAS. Frequency: Frequent (HP:0040282). (ORPHA:2495)
- Headache (HP:0002315): Cephalgia, or pain sensed in various parts of the head, not confined to the area of distribution of any nerve. Evidence: TAS. Frequency: Frequent (HP:0040282). (ORPHA:2495)
- Decreased circulating ACTH concentration (HP:0002920): The concentration of corticotropin, also known as adrenocorticotropic hormone (ACTH), is below the lower limit of normal in the blood circulation. Evidence: TAS. Frequency: Frequent (HP:0040282). (ORPHA:2495)
- Focal-onset seizure (HP:0007359): A focal-onset seizure is a type of seizure originating within networks limited to one hemisphere. They may be discretely localized or more widely distributed, and may originate in subcortical structures. Evidence: TAS. Frequency: Frequent (HP:0040282). (ORPHA:2495)
- Decreased circulating cortisol level (HP:0008163): Abnormally reduced concentration of cortisol in the blood. Evidence: TAS. Frequency: Frequent (HP:0040282). (ORPHA:2495)
- Decreased serum estradiol (HP:0008214): A reduction below normal concentration of estradiol in the circulation. Evidence: TAS. Frequency: Frequent (HP:0040282). (ORPHA:2495)
- Secondary growth hormone deficiency (HP:0008240). Evidence: TAS. Frequency: Frequent (HP:0040282). (ORPHA:2495)
- Pituitary hypothyroidism (HP:0008245): A type of hypothyroidism that results from a defect in thyroid-stimulating hormone secretion. Evidence: TAS. Frequency: Frequent (HP:0040282). (ORPHA:2495)
- Abnormal brain FDG positron emission tomography (HP:0012658): An anomaly detectable in [18F]-fluorodeoxyglucose (FDG) positron emission tomography (PET) brain scans. Glucose uptake measured with FDG-PET is a marker of neuronal metabolic activity. Evidence: TAS. Frequency: Frequent (HP:0040282). (ORPHA:2495)
- Focal T2 hypointense thalamic lesion (HP:0012691): A darker than expected T2 signal on magnetic resonance imaging (MRI) of the thalamus. This term refers to a localized hypointensity affecting a particular region of the thalamus. Evidence: TAS. Frequency: Frequent (HP:0040282). (ORPHA:2495)
- Decreased circulating follicle stimulating hormone concentration (HP:0030341): A reduction of the circulating level of follicle-stimulating hormone (FSH). Evidence: TAS. Frequency: Frequent (HP:0040282). (ORPHA:2495)
- Decreased circulating luteinizing hormone level (HP:0030344): A reduction in the circulating level of luteinizing hormone (LH). Evidence: TAS. Frequency: Frequent (HP:0040282). (ORPHA:2495)
- Bitemporal hemianopia (HP:0030521). Evidence: TAS. Frequency: Frequent (HP:0040282). (ORPHA:2495)
- Decreased serum testosterone concentration (HP:0040171). Evidence: TAS. Frequency: Frequent (HP:0040282). (ORPHA:2495)
- Hydrocephalus (HP:0000238): Hydrocephalus is an active distension of the ventricular system of the brain resulting from inadequate passage of CSF from its point of production within the cerebral ventricles to its point of absorption into the systemic circulation. Evidence: TAS. Frequency: Occasional (HP:0040283). (ORPHA:2495)
- Ophthalmoplegia (HP:0000602): Paralysis of one or more extraocular muscles that are responsible for eye movements. Evidence: TAS. Frequency: Occasional (HP:0040283). (ORPHA:2495)
- Neurofibroma (HP:0001067): A benign peripheral nerve sheath tumor that generally appears as a soft, skin-colored papule or small subcutaneous nodule. Individuals with neurofibromatosis can have numerous neurofibromas. Evidence: TAS. Frequency: Occasional (HP:0040283). (ORPHA:2495)
- Papilledema (HP:0001085): Papilledema refers to edema (swelling) of the optic disc secondary to any factor which increases cerebral spinal fluid pressure. Evidence: TAS. Frequency: Occasional (HP:0040283). (ORPHA:2495)
- Ataxia (HP:0001251): Ataxia refers to impaired coordination of voluntary muscle movement. Cerebellar ataxia refers to ataxia due to dysfunction of the cerebellum. This causes a variety of elementary neurological deficits including asynergy (lack of coordination between muscles, limbs and joints), dysmetria (lack of ability to judge distances that can lead to under- or overshoot in grasping movements), and dysdiadochokinesia (inability to perform rapid movements requiring antagonizing muscle groups to be switched on and off repeatedly). Evidence: TAS. Frequency: Occasional (HP:0040283). (ORPHA:2495)
- Hemiparesis (HP:0001269): Loss of strength in the arm, leg, and sometimes face on one side of the body. Hemiplegia refers to a complete loss of strength, whereas hemiparesis refers to an incomplete loss of strength. Evidence: TAS. Frequency: Occasional (HP:0040283). (ORPHA:2495)
- Abnormal cerebellum morphology (HP:0001317): Any structural abnormality of the cerebellum. Evidence: TAS. Frequency: Occasional (HP:0040283). (ORPHA:2495)
- Obesity (HP:0001513): Accumulation of substantial excess body fat. Evidence: TAS. Frequency: Occasional (HP:0040283). (ORPHA:2495)
- Memory impairment (HP:0002354): An impairment of memory as manifested by a reduced ability to remember things such as dates and names, and increased forgetfulness. Evidence: TAS. Frequency: Occasional (HP:0040283). (ORPHA:2495)
- Increased intracranial pressure (HP:0002516): An increase of the pressure inside the cranium (skull) and thereby in the brain tissue and cerebrospinal fluid. Evidence: TAS. Frequency: Occasional (HP:0040283). (ORPHA:2495)
- Upper limb muscle weakness (HP:0003484): Weakness of the muscles of the arms. Evidence: TAS. Frequency: Occasional (HP:0040283). (ORPHA:2495)
- Functional motor deficit (HP:0004302). Evidence: TAS. Frequency: Occasional (HP:0040283). (ORPHA:2495)
- Abnormality of the sense of smell (HP:0004408): An anomaly in the ability to perceive and distinguish scents (odors). Evidence: TAS. Frequency: Occasional (HP:0040283). (ORPHA:2495)
- Cranial nerve paralysis (HP:0006824). Evidence: TAS. Frequency: Occasional (HP:0040283). (ORPHA:2495)
- Lower limb muscle weakness (HP:0007340): Weakness of the muscles of the legs. Evidence: TAS. Frequency: Occasional (HP:0040283). (ORPHA:2495)
- Weak extraocular muscles (HP:0007715). Evidence: TAS. Frequency: Occasional (HP:0040283). (ORPHA:2495)
- Slow decrease in visual acuity (HP:0007924). Evidence: TAS. Frequency: Occasional (HP:0040283). (ORPHA:2495)
- Reduced circulating prolactin concentration (HP:0008202): A reduced level of prolactin in the blood circulation. Prolactin is a protein hormone that is secreted by lactotrophs in the anterior pituitary and that stimulates mammary gland development and milk production. Evidence: TAS. Frequency: Occasional (HP:0040283). (ORPHA:2495)
- Hypothalamic hypothyroidism (HP:0008237): A type of hypothyroidism that results from a defect in thyrotropin-releasing hormone activity. Evidence: TAS. Frequency: Occasional (HP:0040283). (ORPHA:2495)
- Facial palsy (HP:0010628): Facial nerve palsy is a dysfunction of cranial nerve VII (the facial nerve) that results in inability to control facial muscles on the affected side with weakness of the muscles of facial expression and eye closure. This can either be present in unilateral or bilateral form. Evidence: TAS. Frequency: Occasional (HP:0040283). (ORPHA:2495)
- Abnormal central motor function (HP:0011442): An anomaly of the control or production of movement in the central nervous system. Evidence: TAS. Frequency: Occasional (HP:0040283). (ORPHA:2495)
- Abnormal central sensory function (HP:0011730): An abnormality of sensation related to CNS function. Assuming the primary sensory modalities are intact and the patient is alert and cooperative, the presence of an abnormality of sensory function may indicate a lesion of a parietal cortex, the thalamocortical projections to the parietal cortex, or the spinal cord. Evidence: TAS. Frequency: Occasional (HP:0040283). (ORPHA:2495)
- Neoplasm of the anterior pituitary (HP:0011750): A tumor (abnormal growth of tissue) of the adenohypophysis, which is also known as the anterior lobe of the pituitary gland. Evidence: TAS. Frequency: Occasional (HP:0040283). (ORPHA:2495)
- Oculomotor nerve palsy (HP:0012246): Reduced ability to control the movement of the eye associated with damage to the third cranial nerve (the oculomotor nerve). Evidence: TAS. Frequency: Occasional (HP:0040283). (ORPHA:2495)
- Abnormal hypothalamus physiology (HP:0012285): An abnormal functionality of the hypothalamus. Evidence: TAS. Frequency: Occasional (HP:0040283). (ORPHA:2495)
- Enlarged pituitary gland (HP:0012505): An abnormally increased size of the pituitary gland. Evidence: TAS. Frequency: Occasional (HP:0040283). (ORPHA:2495)
- Visual acuity test abnormality (HP:0030532). Evidence: TAS. Frequency: Occasional (HP:0040283). (ORPHA:2495)
- Abnormal kinetic perimetry test (HP:0030591). Evidence: TAS. Frequency: Occasional (HP:0040283). (ORPHA:2495)
- Spinal meningioma (HP:0100010). Evidence: TAS. Frequency: Occasional (HP:0040283). (ORPHA:2495)
- Cognitive impairment (HP:0100543): Abnormal cognition is characterized by deficits in thinking, reasoning, or remembering. Evidence: TAS. Frequency: Occasional (HP:0040283). (ORPHA:2495)
- Trigeminal neuralgia (HP:0100661): A neuropathic disorder characterized by episodes of intense pain in the face, originating from the trigeminal nerve. One, two, or all three branches of the nerve may be affected. Evidence: TAS. Frequency: Occasional (HP:0040283). (ORPHA:2495)
- Urinary incontinence (HP:0000020): Loss of the ability to control the urinary bladder leading to involuntary urination. Evidence: TAS. Frequency: Very rare (HP:0040284). (ORPHA:2495)
- Tinnitus (HP:0000360): Tinnitus is an auditory perception that can be described as the experience of sound, in the ear or in the head, in the absence of external acoustic stimulation. Evidence: TAS. Frequency: Very rare (HP:0040284). (ORPHA:2495)
- Proptosis (HP:0000520): An eye that is protruding anterior to the plane of the face to a greater extent than is typical. Evidence: TAS. Frequency: Very rare (HP:0040284). (ORPHA:2495)
- Blindness (HP:0000618): Blindness is the condition of lacking visual perception defined as a profound reduction in visual perception. On the 6m visual acuity scale, blindness is defined as less than 3/60. On the 20ft visual acuity scale, blindness is defined as less than 20/400. On the decimal visual acuity scale, blindness is defined as less than 0.05. Blindness is typically characterized by a visual field of no greater than 10 degrees in radius around central fixation. Evidence: TAS. Frequency: Very rare (HP:0040284). (ORPHA:2495)
- Emotional lability (HP:0000712): Unstable emotional experiences and frequent mood changes; emotions that are easily aroused, intense, and/or disproportionate to events and circumstances. Evidence: TAS. Frequency: Very rare (HP:0040284). (ORPHA:2495)
- Excessive daytime somnolence (HP:0001262): A state of abnormally strong desire for sleep during the daytime. Evidence: TAS. Frequency: Very rare (HP:0040284). (ORPHA:2495)
- Syncope (HP:0001279): A transient loss of consciousness (i.e., characterized by a rapid onset, a short duration, and a spontaneous and complete recovery) due to cerebral hypoperfusion. Evidence: TAS. Frequency: Very rare (HP:0040284). (ORPHA:2495)
- Cerebral hemorrhage (HP:0001342): Hemorrhage into the parenchyma of the brain. Evidence: TAS. Frequency: Very rare (HP:0040284). (ORPHA:2495)
- Abnormal speech pattern (HP:0002167): An abnormality in the sound (volume) or cadence (rate) of speech. Evidence: TAS. Frequency: Very rare (HP:0040284). (ORPHA:2495)
- Brain stem compression (HP:0002512). Evidence: TAS. Frequency: Very rare (HP:0040284). (ORPHA:2495)
- Back pain (HP:0003418): An unpleasant sensation characterized by physical discomfort (such as pricking, throbbing, or aching) localized to the back. Evidence: TAS. Frequency: Very rare (HP:0040284). (ORPHA:2495)
- Progressive pulmonary function impairment (HP:0006520). Evidence: TAS. Frequency: Very rare (HP:0040284). (ORPHA:2495)
- Neoplasm of the skin (HP:0008069): A tumor (abnormal growth of tissue) of the skin. Evidence: TAS. Frequency: Very rare (HP:0040284). (ORPHA:2495)
- Transient global amnesia (HP:0010534): A paroxysmal, transient loss of memory function with preservation of immediate recall and remote memory but with a severe impairment of memory for recent events and ability to retain new information. Evidence: TAS. Frequency: Very rare (HP:0040284). (ORPHA:2495)
- Hemifacial spasm (HP:0010828): Intermittent clonic or tonic contraction of muscles supplied by facial nerve. Muscles are relaxed in between contractions. Evidence: TAS. Frequency: Very rare (HP:0040284). (ORPHA:2495)
- Neoplasm of the posterior pituitary (HP:0011752): The presence of a neoplasm (tumor) in the neurohypophysis, which is also known as the posterior lobe of the hypophysis. Evidence: TAS. Frequency: Very rare (HP:0040284). (ORPHA:2495)
- Ear pain (HP:0030766): Pain in the ear can be a consequence of otologic disease (primary or otogenic otalgia), or can arise from pathologic processes and structures other than the ear (secondary or referred otalgia). Evidence: TAS. Frequency: Very rare (HP:0040284). (ORPHA:2495)
- Abnormality on pulmonary function testing (HP:0030878): Any anomaly measure by pulmonary function testing, which includes spirometry, measures of diffusing capacity, and plethysmography. Evidence: TAS. Frequency: Very rare (HP:0040284). (ORPHA:2495)
- Abnormal mediastinum morphology (HP:0045026): Any structural anomaly of the central compartment of the thoracic cavity. Evidence: TAS. Frequency: Very rare (HP:0040284). (ORPHA:2495)
- Neoplasm of the tongue (HP:0100648): A tumor (abnormal growth of tissue) of the tongue. Evidence: TAS. Frequency: Very rare (HP:0040284). (ORPHA:2495)
- Gait disturbance (HP:0001288): The term gait disturbance can refer to any disruption of the ability to walk. Evidence: TAS. Frequency: Occasional (HP:0040283). (ORPHA:2495)